Phenotypes associated with the disease amastia, bilateral, with ureteral triplication and dysmorphism (OMIM:104350):
- Epicanthus (HP:0000286): A fold of skin starting above the medial aspect of the upper eyelid and arching downward to cover, pass in front of and lateral to the medial canthus. Evidence: IEA. (OMIM:104350)
- Ureteral triplication (HP:0008705). Evidence: IEA. (OMIM:104350)
- Downslanted palpebral fissures (HP:0000494): The palpebral fissure inclination is more than two standard deviations below the mean. Evidence: IEA. (OMIM:104350)
- Congenital hip dislocation (HP:0001374). Evidence: IEA. (OMIM:104350)
- Wide nasal bridge (HP:0000431): Increased breadth of the nasal bridge (and with it, the nasal root). Evidence: IEA. (OMIM:104350)
- Scoliosis (HP:0002650): The presence of an abnormal lateral curvature of the spine. Evidence: IEA. (OMIM:104350)
- Absent nipple (HP:0002561): Congenital failure to develop, and absence of, the nipple. Evidence: IEA. (OMIM:104350)
- Depressed nasal bridge (HP:0005280): Posterior positioning of the nasal root in relation to the overall facial profile for age. Evidence: IEA. (OMIM:104350)
- Hemivertebrae (HP:0002937): Absence of one half of the vertebral body. Evidence: IEA. (OMIM:104350)
- Ptosis (HP:0000508): The upper eyelid margin is positioned 3 mm or more lower than usual and covers the superior portion of the iris (objective); or, the upper lid margin obscures at least part of the pupil (subjective). Evidence: IEA. (OMIM:104350)
- Hypertelorism (HP:0000316): Interpupillary distance more than 2 SD above the mean (alternatively, the appearance of an increased interpupillary distance or widely spaced eyes). Evidence: IEA. (OMIM:104350)
- Pectus excavatum (HP:0000767): A defect of the chest wall characterized by a depression of the sternum, giving the chest ("pectus") a caved-in ("excavatum") appearance. Evidence: IEA. (OMIM:104350)
- Umbilical hernia (HP:0001537): Protrusion of abdominal contents through a defect in the abdominal wall musculature around the umbilicus. Skin and subcutaneous tissue overlie the defect. Evidence: IEA. (OMIM:104350)
- Hydrocephalus (HP:0000238): Hydrocephalus is an active distension of the ventricular system of the brain resulting from inadequate passage of CSF from its point of production within the cerebral ventricles to its point of absorption into the systemic circulation. Evidence: IEA. (OMIM:104350)
- High palate (HP:0000218): Height of the palate more than 2 SD above the mean (objective) or palatal height at the level of the first permanent molar more than twice the height of the teeth (subjective). Evidence: IEA. (OMIM:104350)
- Cubitus valgus (HP:0002967): Abnormal positioning in which the elbows are turned out. Evidence: IEA. (OMIM:104350)
- Syndactyly (HP:0001159): Webbing or fusion of the fingers or toes, involving soft parts only or including bone structure. Bony fusions are referred to as "bony" syndactyly if the fusion occurs in a radio-ulnar axis. Fusions of bones of the fingers or toes in a proximo-distal axis are referred to as "symphalangism". Evidence: IEA. (OMIM:104350)
- Patent ductus arteriosus (HP:0001643): In utero, the ductus arteriosus (DA) serves to divert ventricular output away from the lungs and toward the placenta by connecting the main pulmonary artery to the descending aorta. A patent ductus arteriosus (PDA) in the first 3 days of life is a physiologic shunt in healthy term and preterm newborn infants, and normally is substantially closed within about 24 hours after bith and completely closed after about three weeks. Failure of physiologcal closure is referred to a persistent or patent ductus arteriosus (PDA). Depending on the degree of left-to-right shunting, PDA can have clinical consequences. Evidence: IEA. (OMIM:104350)
- Autosomal dominant inheritance (HP:0000006): A mode of inheritance that is observed for traits related to a gene encoded on one of the autosomes (i.e., the human chromosomes 1-22) in which a trait manifests in heterozygotes. In the context of medical genetics, an autosomal dominant disorder is caused when a single copy of the mutant allele is present. Males and females are affected equally, and can both transmit the disorder with a risk of 50% for each child of inheriting the mutant allele. Evidence: IEA. (OMIM:104350)
- Low-set ears (HP:0000369): Upper insertion of the ear to the scalp below an imaginary horizontal line drawn between the inner canthi of the eye and extending posteriorly to the ear. Evidence: IEA. (OMIM:104350)
- Mitral valve prolapse (HP:0001634): One or both of the leaflets (cusps) of the mitral valve bulges back into the left atrium upon contraction of the left ventricle. Evidence: IEA. (OMIM:104350)
- Hydronephrosis (HP:0000126): Severe distention of the kidney with dilation of the renal pelvis and calices. Evidence: IEA. (OMIM:104350)